- Breast carcinoma (HP:0003002): The presence of a carcinoma of the breast. Evidence: PCS. (PMID:11479205)
- Meningioma (HP:0002858): The presence of a meningioma, i.e., a benign tumor originating from the dura mater or arachnoid mater. Evidence: PCS. (PMID:11479205)
- Glioma (HP:0009733): The presence of a glioma, which is a neoplasm of the central nervous system originating from a glial cell (astrocytes or oligodendrocytes). Evidence: PCS. (PMID:10617473)
- Stomach cancer (HP:0012126): A cancer arising in any part of the stomach. Evidence: PCS. (PMID:11479205)
- Autosomal dominant inheritance (HP:0000006): A mode of inheritance that is observed for traits related to a gene encoded on one of the autosomes (i.e., the human chromosomes 1-22) in which a trait manifests in heterozygotes. In the context of medical genetics, an autosomal dominant disorder is caused when a single copy of the mutant allele is present. Males and females are affected equally, and can both transmit the disorder with a risk of 50% for each child of inheriting the mutant allele. Evidence: PCS. (PMID:10617473)
- Sarcoma (HP:0100242): A connective tissue neoplasm formed by proliferation of mesodermal cells. Bone and soft tissue sarcomas are the main types of sarcoma. Sarcoma is usually highly malignant. Evidence: PCS. (PMID:10617473)
These phenotypes are associated with the disease Li-Fraumeni syndrome 2 (OMIM:609265).